Phenotypes associated with the disease Bacterial toxic-shock syndrome (ORPHA:36234):
- Hypotension (HP:0002615): Low Blood Pressure, vascular hypotension. Evidence: TAS. Frequency: Very frequent (HP:0040281). (ORPHA:36234)
- Shock (HP:0031273): The state in which profound and widespread reduction of effective tissue perfusion leads first to reversible, and then if prolonged, to irreversible cellular injury. Evidence: TAS. Frequency: Very frequent (HP:0040281). (ORPHA:36234)
- Severe infection (HP:0032169): A type of infection that is regarded as a sign of a pathological susceptibility to infection because of unusual severity or intensity of the infection. Evidence: TAS. Frequency: Very frequent (HP:0040281). (ORPHA:36234)
- Confusion (HP:0001289): Lack of clarity and coherence of thought, perception, understanding, or action. Evidence: TAS. Frequency: Frequent (HP:0040282). (ORPHA:36234)
- Recurrent skin infections (HP:0001581): Infections of the skin that happen multiple times. Evidence: TAS. Frequency: Frequent (HP:0040282). (ORPHA:36234)
- Tachycardia (HP:0001649): A rapid heartrate that exceeds the range of the normal resting heartrate for age. Evidence: TAS. Frequency: Frequent (HP:0040282). (ORPHA:36234)
- Metabolic acidosis (HP:0001942): Metabolic acidosis (MA) is characterized by a fall in blood pH due to a reduction of serum bicarbonate concentration. This can occur as a result of either the accumulation of acids (high anion gap MA) or the loss of bicarbonate from the gastrointestinal tract or the kidney (hyperchloremic MA). By definition, MA is not due to a respirary cause. Evidence: TAS. Frequency: Frequent (HP:0040282). (ORPHA:36234)
- Fever (HP:0001945): Body temperature elevated above the normal range. Evidence: TAS. Frequency: Frequent (HP:0040282). (ORPHA:36234)
- Abdominal pain (HP:0002027): An unpleasant sensation characterized by physical discomfort (such as pricking, throbbing, or aching) and perceived to originate in the abdomen. Evidence: TAS. Frequency: Frequent (HP:0040282). (ORPHA:36234)
- Respiratory distress (HP:0002098): Respiratory distress is objectively observable as the physical or emotional consequences from the experience of dyspnea. The physical presentation of respiratory distress is generally referred to as labored breathing, while the sensation of respiratory distress is called shortness of breath or dyspnea. Evidence: TAS. Frequency: Frequent (HP:0040282). (ORPHA:36234)
- Increased circulating lactate concentration (HP:0002151): Abnormally increased level of blood lactate (2-hydroxypropanoic acid). Lactate is produced from pyruvate by lactate dehydrogenase during normal metabolism. The terms lactate and lactic acid are often used interchangeably but lactate (the component measured in blood) is strictly a weak base whereas lactic acid is the corresponding acid. Lactic acidosis is often used clinically to describe elevated lactate but should be reserved for cases where there is a corresponding acidosis (pH below 7.35). Evidence: TAS. Frequency: Frequent (HP:0040282). (ORPHA:36234)
- Myalgia (HP:0003326): Pain in muscle. Evidence: TAS. Frequency: Frequent (HP:0040282). (ORPHA:36234)
- Abnormality of facial soft tissue (HP:0011799). Evidence: TAS. Frequency: Frequent (HP:0040282). (ORPHA:36234)
- Pain (HP:0012531): An unpleasant sensory and emotional experience associated with actual or potential tissue damage, or described in terms of such damage. Evidence: TAS. Frequency: Frequent (HP:0040282). (ORPHA:36234)
- Fasciitis (HP:0100537): Inflammation of fascia, the tissue under the skin and over the muscle. Evidence: TAS. Frequency: Frequent (HP:0040282). (ORPHA:36234)
- Renal insufficiency (HP:0000083): A reduction in the level of performance of the kidneys in areas of function comprising the concentration of urine, removal of wastes, the maintenance of electrolyte balance, homeostasis of blood pressure, and calcium metabolism. Evidence: TAS. Frequency: Occasional (HP:0040283). (ORPHA:36234)
- Glomerulonephritis (HP:0000099): Inflammation of the renal glomeruli. Evidence: TAS. Frequency: Occasional (HP:0040283). (ORPHA:36234)
- Sinusitis (HP:0000246): Inflammation of the paranasal sinuses owing to a viral, bacterial, or fungal infection, allergy, or an autoimmune reaction. Evidence: TAS. Frequency: Occasional (HP:0040283). (ORPHA:36234)
- Skin rash (HP:0000988): A red eruption of the skin. Evidence: TAS. Frequency: Occasional (HP:0040283). (ORPHA:36234)
- Meningitis (HP:0001287): Inflammation of the meninges. Evidence: TAS. Frequency: Occasional (HP:0040283). (ORPHA:36234)
- Arthritis (HP:0001369): Inflammation of a joint. Evidence: TAS. Frequency: Occasional (HP:0040283). (ORPHA:36234)
- Thrombocytopenia (HP:0001873): A reduction in the number of circulating thrombocytes. Evidence: TAS. Frequency: Occasional (HP:0040283). (ORPHA:36234)
- Vomiting (HP:0002013): Forceful ejection of the contents of the stomach through the mouth by means of a series of involuntary spasmic contractions. Evidence: TAS. Frequency: Occasional (HP:0040283). (ORPHA:36234)
- Diarrhea (HP:0002014): Abnormally increased frequency (usually defined as three or more) loose or watery bowel movements a day. Evidence: TAS. Frequency: Occasional (HP:0040283). (ORPHA:36234)
- Nausea (HP:0002018): A sensation of unease in the stomach together with an urge to vomit. Evidence: TAS. Frequency: Occasional (HP:0040283). (ORPHA:36234)
- Pneumonia (HP:0002090): Inflammation of any part of the lung parenchyma. Evidence: TAS. Frequency: Occasional (HP:0040283). (ORPHA:36234)
- Infectious encephalitis (HP:0002383): A disorder of the brain caused by an infectious agent that presents with fever, headache, and an altered level of consciousness. There may also be focal or multifocal neurologic deficits, and focal or generalized seizure activity. Evidence: TAS. Frequency: Occasional (HP:0040283). (ORPHA:36234)
- Peritonitis (HP:0002586): Inflammation of the peritoneum. Evidence: TAS. Frequency: Occasional (HP:0040283). (ORPHA:36234)
- Osteomyelitis (HP:0002754): Osteomyelitis is an inflammatory process accompanied by bone destruction and caused by an infecting microorganism. Evidence: TAS. Frequency: Occasional (HP:0040283). (ORPHA:36234)
- Tachypnea (HP:0002789): Very rapid breathing. Evidence: TAS. Frequency: Occasional (HP:0040283). (ORPHA:36234)
- Abnormality of the lower limb (HP:0002814): An abnormality of the leg. Evidence: TAS. Frequency: Occasional (HP:0040283). (ORPHA:36234)
- Abnormality of the upper limb (HP:0002817): An abnormality of the arm. Evidence: TAS. Frequency: Occasional (HP:0040283). (ORPHA:36234)
- Hypocalcemia (HP:0002901): The concentration of calcium in the blood circulation is below the lower limit of normal. Evidence: TAS. Frequency: Occasional (HP:0040283). (ORPHA:36234)
- Hypoalbuminemia (HP:0003073): The concentration of albumin in the blood circulation is below the lower limit of normal. Evidence: TAS. Frequency: Occasional (HP:0040283). (ORPHA:36234)
- Septic arthritis (HP:0003095). Evidence: TAS. Frequency: Occasional (HP:0040283). (ORPHA:36234)
- Elevated circulating creatine kinase activity (HP:0003236): The activity of creatine kinase in the blood circulation is above the upper limit of normal. Evidence: TAS. Frequency: Occasional (HP:0040283). (ORPHA:36234)
- Elevated circulating creatinine concentration (HP:0003259): An increased amount of creatinine in the blood. Evidence: TAS. Frequency: Occasional (HP:0040283). (ORPHA:36234)
- Disseminated intravascular coagulation (HP:0005521): Disseminated intravascular coagulation is characterized by the widespread activation of coagulation, which results in the intravascular formation of fibrin and ultimately thrombotic occlusion of small and midsize vessels. Evidence: TAS. Frequency: Occasional (HP:0040283). (ORPHA:36234)
- Abnormal blistering of the skin (HP:0008066): The presence of one or more bullae on the skin, defined as fluid-filled blisters more than 5 mm in diameter with thin walls. Evidence: TAS. Frequency: Occasional (HP:0040283). (ORPHA:36234)
- Localized skin lesion (HP:0011355): A lesion of the skin that is located in a specific region rather than being generalized. Evidence: TAS. Frequency: Occasional (HP:0040283). (ORPHA:36234)
- Respiratory tract infection (HP:0011947): An infection of the upper or lower respiratory tract. Evidence: TAS. Frequency: Occasional (HP:0040283). (ORPHA:36234)
- Hepatitis (HP:0012115): Inflammation of the liver. Evidence: TAS. Frequency: Occasional (HP:0040283). (ORPHA:36234)
- Myocarditis (HP:0012819): Inflammation of the myocardium. Evidence: TAS. Frequency: Occasional (HP:0040283). (ORPHA:36234)
- Chills (HP:0025143): A sudden sensation of feeling cold. Evidence: TAS. Frequency: Occasional (HP:0040283). (ORPHA:36234)
- Pharyngitis (HP:0025439): Inflammation (due to infection or irritation) of the pharynx. Evidence: TAS. Frequency: Occasional (HP:0040283). (ORPHA:36234)
- Abscess (HP:0025615): An abscess is a localized collection of purulent material surrounded by inflammation and granulation. Evidence: TAS. Frequency: Occasional (HP:0040283). (ORPHA:36234)
- Capillary leak (HP:0030005): An acute phenomenon characterized by hypotension and anasarca due to the loss of plasma volume into peripheral tissues, with evidence of decreased plasma volume (hemoconcentration) and protein loss from the intravascular space (hypoalbuminemia) during acute episodes. Evidence: TAS. Frequency: Occasional (HP:0040283). (ORPHA:36234)
- Ecchymosis (HP:0031364): A purpuric lesion that is larger than 1 cm in diameter. Evidence: TAS. Frequency: Occasional (HP:0040283). (ORPHA:36234)
- Severe viral infection (HP:0031691): An unusually severe viral infection. Evidence: TAS. Frequency: Occasional (HP:0040283). (ORPHA:36234)
- Bacteremia (HP:0031864): Presence of viable bacteria in the blood. Evidence: TAS. Frequency: Occasional (HP:0040283). (ORPHA:36234)
- Severe varicella zoster infection (HP:0032170): An unusually severe form of varicella zoster virus (VZV) infection. In the majority of the cases, especially in children, varicella is a very mild infection characterized by skin lesions, low grade fever and malaise. Severe infection is characterized by manifestations including VZV pneumonia, hepatitis, meningitis, and disseminated varicella. Evidence: TAS. Frequency: Occasional (HP:0040283). (ORPHA:36234)
- Increased circulating myelocyte count (HP:0032237): The number of myelocytes in the peripheral blood circulation is above the upper limit of normal. Myelocytes are immature neutrophils with a size of 12-18 micrometers, a round or oval nucleus with no nucleoli, bluish-pink staining cytoplasm with primary and secondary granules, and a nucleus:cytoplasm ratio of 2:1. Evidence: TAS. Frequency: Occasional (HP:0040283). (ORPHA:36234)
- Increased circulating metamyelocyte count (HP:0032238): The number of metamyelocytes in the peripheral blood circulation is above the upper limit of normal. Metamyelocytes are immature neutrophils with a size of 10-18 micrometers, an indented or kidney-shaped nucleus, pinkish-blue staining cytoplasm with secondary granules, and a nucleus:cytoplasm ratio of 1.5:1. Evidence: TAS. Frequency: Occasional (HP:0040283). (ORPHA:36234)
- Acute cutaneous wound (HP:0032675): A cutaneous wound that is proceeding through an orderly and timely reparative process that results in sustained restoration of the anatomic and functional integrity of the skin. Evidence: TAS. Frequency: Occasional (HP:0040283). (ORPHA:36234)
- Scaling skin (HP:0040189): Refers to the loss of the outer layer of the epidermis in large, scale-like flakes. Evidence: TAS. Frequency: Occasional (HP:0040283). (ORPHA:36234)
- Myositis (HP:0100614): A general term for inflammation of the muscles without respect to the underlying cause. Evidence: TAS. Frequency: Occasional (HP:0040283). (ORPHA:36234)
- Cellulitis (HP:0100658): A bacterial infection and inflammation of the skin und subcutaneous tissues. Evidence: TAS. Frequency: Occasional (HP:0040283). (ORPHA:36234)
- Sepsis (HP:0100806): Sepsis is defined as life-threatening organ dysfunction caused by a dysregulated host response to infection. Evidence: TAS. Frequency: Occasional (HP:0040283). (ORPHA:36234)
- Recurrent urinary tract infections (HP:0000010): Repeated infections of the urinary tract. Evidence: TAS. Frequency: Very rare (HP:0040284). (ORPHA:36234)
- Edema (HP:0000969): An abnormal accumulation of fluid beneath the skin, or in one or more cavities of the body. Evidence: TAS. Frequency: Very rare (HP:0040284). (ORPHA:36234)